- Juvenile onset (HP:0003621): Onset of signs or symptoms of disease between the age of 5 and 15 years. Evidence: TAS. (OMIM:132300)
- EEG abnormality (HP:0002353): Abnormality observed by electroencephalogram (EEG), which is used to record of the brain's spontaneous electrical activity from multiple electrodes placed on the scalp. Evidence: TAS. (OMIM:132300)
- Seizure (HP:0001250): A seizure is an intermittent abnormality of nervous system physiology characterized by a transient occurrence of signs and/or symptoms due to abnormal excessive or synchronous neuronal activity in the brain. Evidence: TAS. (OMIM:132300)
- Autosomal dominant inheritance (HP:0000006): A mode of inheritance that is observed for traits related to a gene encoded on one of the autosomes (i.e., the human chromosomes 1-22) in which a trait manifests in heterozygotes. In the context of medical genetics, an autosomal dominant disorder is caused when a single copy of the mutant allele is present. Males and females are affected equally, and can both transmit the disorder with a risk of 50% for each child of inheriting the mutant allele. Evidence: TAS. (OMIM:132300)
These phenotypes are associated with the disease reading seizures (OMIM:132300).